Phenotypes associated with the disease Interatrial communication (ORPHA:1478):
- Atrial septal defect (HP:0001631): Atrial septal defect (ASD) is a congenital abnormality of the interatrial septum that enables blood flow between the left and right atria via the interatrial septum. Evidence: TAS. Frequency: Very frequent (HP:0040281). (ORPHA:1478)
- Secundum atrial septal defect (HP:0001684): A kind of atrial septum defect arising from an enlarged foramen ovale, inadequate growth of the septum secundum, or excessive absorption of the septum primum. Evidence: TAS. Frequency: Very frequent (HP:0040281). (ORPHA:1478)
- Atrial fibrillation (HP:0005110): An atrial arrhythmia characterized by disorganized atrial activity without discrete P waves on the surface EKG, but instead by an undulating baseline or more sharply circumscribed atrial deflections of varying amplitude an frequency ranging from 350 to 600 per minute. Evidence: TAS. Frequency: Frequent (HP:0040282). (ORPHA:1478)
- Systolic heart murmur (HP:0031664): A heart murmur limited to systole, i.e., between the first and second heart sounds S1 and S2. Evidence: TAS. Frequency: Frequent (HP:0040282). (ORPHA:1478)
- Congestive heart failure (HP:0001635): The presence of an abnormality of cardiac function that is responsible for the failure of the heart to pump blood at a rate that is commensurate with the needs of the tissues or a state in which abnormally elevated filling pressures are required for the heart to do so. Heart failure is frequently related to a defect in myocardial contraction. Evidence: TAS. Frequency: Occasional (HP:0040283). (ORPHA:1478)
- Cardiomegaly (HP:0001640): Increased size of the heart, clinically defined as an increased transverse diameter of the cardiac silhouette that is greater than or equal to 50% of the transverse diameter of the chest (increased cardiothoracic ratio) on a posterior-anterior projection of a chest radiograph or a computed tomography. Evidence: TAS. Frequency: Occasional (HP:0040283). (ORPHA:1478)
- Palpitations (HP:0001962): A sensation that the heart is pounding or racing, which is a non-specific sign but may be a manifestation of arrhythmia. Evidence: TAS. Frequency: Occasional (HP:0040283). (ORPHA:1478)
- Pulmonary arterial hypertension (HP:0002092): Pulmonary hypertension is defined mean pulmonary artery pressure of 25mmHg or more and pulmonary capillary wedge pressure of 15mmHg or less when measured by right heart catheterisation at rest and in a supine position. Evidence: TAS. Frequency: Occasional (HP:0040283). (ORPHA:1478)
- Recurrent respiratory infections (HP:0002205): An increased susceptibility to respiratory infections as manifested by a history of recurrent respiratory infections. Evidence: TAS. Frequency: Occasional (HP:0040283). (ORPHA:1478)
- Exertional dyspnea (HP:0002875): Perceived difficulty to breathe that occurs with exercise or exertion and improves with rest. Evidence: TAS. Frequency: Occasional (HP:0040283). (ORPHA:1478)
- Atrial flutter (HP:0004749): A type of atrial arrhythmia characterized by atrial rates of between 240 and 400 beats per minute and some degree of atrioventricular node conduction block. Typically, the ventricular rate is half the atrial rate. In the EKG; atrial flutter waves are observed as sawtooth-like atrial activity. Pathophysiologically, atrial flutter is a form of atrial reentry in which there is a premature electrical impulse creates a self-propagating circuit. Evidence: TAS. Frequency: Occasional (HP:0040283). (ORPHA:1478)
- Right ventricular dilatation (HP:0005133): Enlargement of the chamber of the right ventricle, which can be defined echocardiographically as a right ventricular to left ventricular ratio greater than 1:1. Evidence: TAS. Frequency: Occasional (HP:0040283). (ORPHA:1478)
- Primum atrial septal defect (HP:0010445): An ostium primum atrial septal defect is located in the most anterior and inferior aspect of the atrial septum. The ostium primum refers to an anterior and inferior opening (ostium) within the septum primum, which divides the rudimentary atrium during fetal development. The ostium primum is normally sealed by fusion of the superior and inferior endocardial cushions around 5 weeks' gestation. Ostium primum defects result from a failure of the fusion of the embryologic endocardial cushion and septum primum. Evidence: TAS. Frequency: Occasional (HP:0040283). (ORPHA:1478)
- Sinus venosus atrial septal defect (HP:0011567): An interatrial communication caused by a deficiency of the common wall between the superior vena cava (SVC) and the right-sided pulmonary veins. SVASD is commonly associated with anomalous pulmonary venous connection (APVC) of some or all of the pulmonary veins, which produces additional left-to-right shunting. Evidence: TAS. Frequency: Occasional (HP:0040283). (ORPHA:1478)
- Complete right bundle branch block (HP:0011712): A conduction block of the right branch of the bundle of His. This manifests as a prolongation of the QRS complex (greater than 0.12 s) with delayed activation of the right ventricle and terminal delay on the EKG. Evidence: TAS. Frequency: Occasional (HP:0040283). (ORPHA:1478)
- Fatigue (HP:0012378): A subjective feeling of tiredness characterized by a lack of energy and motivation. Evidence: TAS. Frequency: Occasional (HP:0040283). (ORPHA:1478)
- Right axis deviation (HP:0033567): A kind of abnormal ventricular axis in the EKG whereby the QRS axis falls between +90 degrees and 180 degrees, or beyond +100 degrees if the adult range is used. Evidence: TAS. Frequency: Occasional (HP:0040283). (ORPHA:1478)
- Stroke (HP:0001297): Sudden impairment of blood flow to a part of the brain due to occlusion or rupture of an artery to the brain. Evidence: TAS. Frequency: Very rare (HP:0040284). (ORPHA:1478)
- Coronary sinus atrial septal defect (HP:0011643): An atrial septal defect characterized by a deficiency in the tissue separating the coronary sinus from the left atrium (LA). This results in partial or complete unroofing of the coronary sinus leading to a predominantly left-to-right shunt through the coronary sinus (LA to coronary sinus to right atrium [RA]). The orifice of the ostium is frequently large because of the increased flow. From the RA side, the defect is located at the level of the coronary sinus ostium and may also include some deficiency in atrial tissue around the ostium. From the LA side, the size can be variable depending on the degree of unroofing of the coronary sinus. There is partial (either focal or fenestrated) or complete absence of the roof of the CS, which results in a communication between the CS and the LA. Unroofed CS is the rarest type of atrial septal defect. It is often associated with persistent left superior vena cava (LSVC) and other forms of complex congenital heart disease, usually heterotaxia syndromes. Evidence: TAS. Frequency: Very rare (HP:0040284). (ORPHA:1478)